Phenotypes associated with the disease GROWTH CONTROL, Y-CHROMOSOME INFLUENCED (OMIM:475000):
- Growth abnormality (HP:0001507). Evidence: IEA. (OMIM:475000)
- Y-linked inheritance (HP:0001450): A mode of inheritance that is observed for traits related to a gene encoded on the Y chromosome. Evidence: IEA. (OMIM:475000)